- Hiatus hernia (HP:0002036): The presence of a hernia in which the upper part of the stomach, i.e., mainly the gastric cardia protrudes through the diaphragmatic esophageal hiatus. Evidence: IEA. (OMIM:142400)
- Autosomal dominant inheritance (HP:0000006): A mode of inheritance that is observed for traits related to a gene encoded on one of the autosomes (i.e., the human chromosomes 1-22) in which a trait manifests in heterozygotes. In the context of medical genetics, an autosomal dominant disorder is caused when a single copy of the mutant allele is present. Males and females are affected equally, and can both transmit the disorder with a risk of 50% for each child of inheriting the mutant allele. Evidence: IEA. (OMIM:142400)
- Abnormal thorax morphology (HP:0000765): Any abnormality of the thorax (the region of the body formed by the sternum, the thoracic vertebrae and the ribs). Evidence: IEA. (OMIM:142400)
These phenotypes are associated with the disease hiatus hernia (OMIM:142400).